- Diarrhea (HP:0002014): Abnormally increased frequency (usually defined as three or more) loose or watery bowel movements a day. Evidence: IEA. (OMIM:250900)
- Aminoaciduria (HP:0003355): An increased concentration of an amino acid in the urine. Evidence: IEA. (OMIM:250900)
- Seizure (HP:0001250): A seizure is an intermittent abnormality of nervous system physiology characterized by a transient occurrence of signs and/or symptoms due to abnormal excessive or synchronous neuronal activity in the brain. Evidence: IEA. (OMIM:250900)
- White hair (HP:0011364): Hypopigmented hair that appears white. Evidence: TAS. (OMIM:250900)
- Blue irides (HP:0000635): A markedly blue coloration of the iris. Evidence: IEA. (OMIM:250900)
- Autosomal recessive inheritance (HP:0000007): A mode of inheritance that is observed for traits related to a gene encoded on one of the autosomes (i.e., the human chromosomes 1-22) in which a trait manifests in individuals with two pathogenic alleles, either homozygotes (two copies of the same mutant allele) or compound heterozygotes (whereby each copy of a gene has a distinct mutant allele). Evidence: IEA. (OMIM:250900)
- Tachypnea (HP:0002789): Very rapid breathing. Evidence: IEA. (OMIM:250900)
- Intellectual disability (HP:0001249): The term intellectual disability or intellectual developmental disorder is used to describe significantly sub-average intellectual and adaptive functioning based on clinical assessment and as measured by individually administered, appropriately normed, standardized and validated tests of intellectual functioning and adaptive behavior, with onset during the developmental period from infancy through adolescence. Evidence: IEA. (OMIM:250900)
- Positive ferric chloride test (HP:0003612): If positive, the ferric chloride test indicates an increased concentration of phenols in the urine or blood. Evidence: IEA. (OMIM:250900)
These phenotypes are associated with the disease methionine malabsorption syndrome (OMIM:250900).